- Anencephaly (HP:0002323): Anencephaly is a developmental anomaly characterized by a fetus that has no calvarium, with a lack of most or all of the fetus' brain tissue. Anencephaly belongs to a collective group known as neural tube defects (NTD) and is a result of the neural tube failing to close in its rostral end during fetal development. Evidence: TAS. Frequency: Very frequent (HP:0040281). (ORPHA:1048)
- Primary adrenal insufficiency (HP:0008207): Insufficient production of steroid hormones (primarily cortisol) by the adrenal glands as a result of a primary defect in the glands themselves. Evidence: TAS. Frequency: Very frequent (HP:0040281). (ORPHA:1048)
These phenotypes are associated with the disease Isolated anencephaly/exencephaly (ORPHA:1048).